Phenotypes associated with the disease chromosome 16p12.2-p11.2 deletion syndrome (DECIPHER:68):
- Abnormality of the face (HP:0000271): An abnormality of the face. Evidence: IEA. (DECIPHER:68)
- Feeding difficulties in infancy (HP:0008872): Impaired feeding performance of an infant as manifested by difficulties such as weak and ineffective sucking, brief bursts of sucking, and falling asleep during sucking. There may be difficulties with chewing or maintaining attention. Evidence: IEA. (DECIPHER:68)
- Pointed chin (HP:0000307): A marked tapering of the lower face to the chin. Evidence: IEA. (DECIPHER:68)
- Intellectual disability (HP:0001249): The term intellectual disability or intellectual developmental disorder is used to describe significantly sub-average intellectual and adaptive functioning based on clinical assessment and as measured by individually administered, appropriately normed, standardized and validated tests of intellectual functioning and adaptive behavior, with onset during the developmental period from infancy through adolescence. Evidence: IEA. (DECIPHER:68)